Phenotypes associated with the disease fibromatosis, gingival, 6 (OMIM:620999):
- Juvenile onset (HP:0003621): Onset of signs or symptoms of disease between the age of 5 and 15 years. Evidence: PCS. Frequency: 2/4. (PMID:35142290)
- Childhood onset (HP:0011463): Onset of disease at the age of between 1 and 5 years. Evidence: PCS. Frequency: 2/4. (PMID:35142290)
- Gingival fibromatosis (HP:0000169): The presence of fibrosis of the gingiva. Evidence: PCS. Frequency: 12/12. (PMID:35142290)
- Autosomal dominant inheritance (HP:0000006): A mode of inheritance that is observed for traits related to a gene encoded on one of the autosomes (i.e., the human chromosomes 1-22) in which a trait manifests in heterozygotes. In the context of medical genetics, an autosomal dominant disorder is caused when a single copy of the mutant allele is present. Males and females are affected equally, and can both transmit the disorder with a risk of 50% for each child of inheriting the mutant allele. Evidence: PCS. (PMID:35142290)